- Tall stature (HP:0000098): A height above that which is expected according to age and gender norms. Evidence: TAS. Frequency: Very frequent (HP:0040281). (ORPHA:314769)
- Macroglossia (HP:0000158): Increased length and width of the tongue. Evidence: TAS. Frequency: Very frequent (HP:0040281). (ORPHA:314769)
- Thick lower lip vermilion (HP:0000179): Increased thickness of the lower lip, leading to a prominent appearance of the lower lip. The height of the vermilion of the lower lip in the midline is more than 2 SD above the mean. Alternatively, an apparently increased height of the vermilion of the lower lip in the frontal view (subjective). Evidence: TAS. Frequency: Very frequent (HP:0040281). (ORPHA:314769)
- Long face (HP:0000276): Facial height (length) is more than 2 standard deviations above the mean (objective); or, an apparent increase in the height (length) of the face (subjective). Evidence: TAS. Frequency: Very frequent (HP:0040281). (ORPHA:314769)
- Coarse facial features (HP:0000280): Absence of fine and sharp appearance of brows, nose, lips, mouth, and chin, usually because of rounded and heavy features or thickened skin with or without thickening of subcutaneous and bony tissues. Evidence: TAS. Frequency: Very frequent (HP:0040281). (ORPHA:314769)
- Full cheeks (HP:0000293): Increased prominence or roundness of soft tissues between zygomata and mandible. Evidence: TAS. Frequency: Very frequent (HP:0040281). (ORPHA:314769)
- Mandibular prognathia (HP:0000303): Abnormal prominence of the chin related to increased length of the mandible. Evidence: TAS. Frequency: Very frequent (HP:0040281). (ORPHA:314769)
- Broad forehead (HP:0000337): Width of the forehead or distance between the frontotemporales is more than two standard deviations above the mean (objective); or apparently increased distance between the two sides of the forehead. Evidence: TAS. Frequency: Very frequent (HP:0040281). (ORPHA:314769)
- Macrotia (HP:0000400): Median longitudinal ear length greater than two standard deviations above the mean and median ear width greater than two standard deviations above the mean (objective); or, apparent increase in length and width of the pinna (subjective). Evidence: TAS. Frequency: Very frequent (HP:0040281). (ORPHA:314769)
- Wide nose (HP:0000445): Interalar distance more than two standard deviations above the mean for age, i.e., an apparently increased width of the nasal base and alae. Evidence: TAS. Frequency: Very frequent (HP:0040281). (ORPHA:314769)
- Anterior hypopituitarism (HP:0000830): A condition of reduced function of the anterior pituitary gland characterized by decreased secretion of one or more of the pituitary hormones growth hormone, thyroid-stimulating hormone, adrenocorticotropic hormone, prolactin, luteinizing hormone, and follicle-stimulating hormone. Evidence: TAS. Frequency: Very frequent (HP:0040281). (ORPHA:314769)
- Elevated circulating growth hormone concentration (HP:0000845): Acromegaly is a condition resulting from overproduction of growth hormone by the pituitary gland in persons with closed epiphyses, and consists chiefly in the enlargement of the distal parts of the body. The circumference of the skull increases, the nose becomes broad, the tongue becomes enlarged, the facial features become coarsened, the mandible grows excessively, and the teeth become separated. The fingers and toes grow chiefly in thickness. Evidence: TAS. Frequency: Very frequent (HP:0040281). (ORPHA:314769)
- Increased circulating prolactin concentration (HP:0000870): The presence of abnormally increased levels of prolactin in the blood. Prolactin is a peptide hormone produced by the anterior pituitary gland that plays a role in breast development and lactation during pregnancy. Evidence: TAS. Frequency: Very frequent (HP:0040281). (ORPHA:314769)
- Hyperhidrosis (HP:0000975): Abnormal excessive perspiration (sweating) despite the lack of appropriate stimuli like hot and humid weather. Evidence: TAS. Frequency: Very frequent (HP:0040281). (ORPHA:314769)
- Thickened skin (HP:0001072): Laminar thickening of skin. Evidence: TAS. Frequency: Very frequent (HP:0040281). (ORPHA:314769)
- Large hands (HP:0001176). Evidence: TAS. Frequency: Very frequent (HP:0040281). (ORPHA:314769)
- Tapered finger (HP:0001182): The gradual reduction in girth of the finger from proximal to distal. Evidence: TAS. Frequency: Very frequent (HP:0040281). (ORPHA:314769)
- Joint swelling (HP:0001386). Evidence: TAS. Frequency: Very frequent (HP:0040281). (ORPHA:314769)
- Broad foot (HP:0001769): A foot for which the measured width is above the 95th centile for age; or, a foot that appears disproportionately wide for its length. Evidence: TAS. Frequency: Very frequent (HP:0040281). (ORPHA:314769)
- Deep plantar creases (HP:0001869): The presence of unusually deep creases (ridges/wrinkles) on the skin of sole of foot. Evidence: TAS. Frequency: Very frequent (HP:0040281). (ORPHA:314769)
- Osteoarthritis (HP:0002758): Degeneration (wear and tear) of articular cartilage, i.e., of the joint surface. Joint degeneration may be accompanied by osteophytes (bone overgrowth), narrowing of the joint space, regions of sclerosis at the joint surface, or joint deformity. Evidence: TAS. Frequency: Very frequent (HP:0040281). (ORPHA:314769)
- Arthralgia (HP:0002829): Joint pain. Evidence: TAS. Frequency: Very frequent (HP:0040281). (ORPHA:314769)
- Cortical diaphyseal thickening of the upper limbs (HP:0003859). Evidence: TAS. Frequency: Very frequent (HP:0040281). (ORPHA:314769)
- Macrodactyly (HP:0004099): Significant increase in the length and girth of most or all of a digit compared to its contralateral digit (if unaffected) or compared to what would be expected for age/body build. The increased girth is accompanied by an increase in the dorso-ventral dimension AND the lateral dimension of the digit. Evidence: TAS. Frequency: Very frequent (HP:0040281). (ORPHA:314769)
- Deep palmar crease (HP:0006191): Excessively deep creases of the palm. Evidence: TAS. Frequency: Very frequent (HP:0040281). (ORPHA:314769)
- Fatigue (HP:0012378): A subjective feeling of tiredness characterized by a lack of energy and motivation. Evidence: TAS. Frequency: Very frequent (HP:0040281). (ORPHA:314769)
- Hypogonadotropic hypogonadism (HP:0000044): Hypogonadotropic hypogonadism is characterized by reduced function of the gonads (testes in males or ovaries in females) and results from the absence of the gonadal stimulating pituitary hormones: follicle stimulating hormone (FSH) and luteinizing hormone (LH). Evidence: TAS. Frequency: Frequent (HP:0040282). (ORPHA:314769)
- Amenorrhea (HP:0000141): Absence of menses for an interval of time equivalent to a total of more than (or equal to) 3 previous cycles or 6 months. Evidence: TAS. Frequency: Frequent (HP:0040282). (ORPHA:314769)
- Abnormality of the dentition (HP:0000164): Any abnormality of the teeth. Evidence: TAS. Frequency: Frequent (HP:0040282). (ORPHA:314769)
- Synophrys (HP:0000664): Meeting of the medial eyebrows in the midline. Evidence: TAS. Frequency: Frequent (HP:0040282). (ORPHA:314769)
- Widely spaced teeth (HP:0000687): Increased spaces (diastemata) between most of the teeth in the same dental arch. Evidence: TAS. Frequency: Frequent (HP:0040282). (ORPHA:314769)
- Depression (HP:0000716): Frequently experiencing feelings of being down, miserable, and/or hopeless; struggling to recover from these moods; having a pessimistic outlook on the future; feeling a pervasive sense of shame; having a low self-worth; experiencing thoughts of suicide and engaging in suicidal behavior. Evidence: TAS. Frequency: Frequent (HP:0040282). (ORPHA:314769)
- Anxiety (HP:0000739): Intense feelings of nervousness, tension, or panic often arise in response to interpersonal stresses. There is worry about the negative effects of past unpleasant experiences and future negative possibilities. Individuals may feel fearful, apprehensive, or threatened by uncertainty, and they may also have fears of falling apart or losing control. Evidence: TAS. Frequency: Frequent (HP:0040282). (ORPHA:314769)
- Diabetes mellitus (HP:0000819): A group of abnormalities characterized by hyperglycemia and glucose intolerance. Evidence: TAS. Frequency: Frequent (HP:0040282). (ORPHA:314769)
- Hypertension (HP:0000822): The presence of chronic increased pressure in the systemic arterial system. Evidence: TAS. Frequency: Frequent (HP:0040282). (ORPHA:314769)
- Abnormal fingernail morphology (HP:0001231): An abnormality of the fingernails. Evidence: TAS. Frequency: Frequent (HP:0040282). (ORPHA:314769)
- Hoarse voice (HP:0001609): Hoarseness refers to a change in the pitch or quality of the voice, with the voice sounding weak, very breathy, scratchy, or husky. Evidence: TAS. Frequency: Frequent (HP:0040282). (ORPHA:314769)
- Frontal bossing (HP:0002007): Bilateral bulging of the lateral frontal bone prominences with relative sparing of the midline. Evidence: TAS. Frequency: Frequent (HP:0040282). (ORPHA:314769)
- Migraine (HP:0002076): Migraine is a chronic neurological disorder characterized by episodic attacks of headache and associated symptoms. Evidence: TAS. Frequency: Frequent (HP:0040282). (ORPHA:314769)
- Generalized hirsutism (HP:0002230): Abnormally increased hair growth over much of the entire body. Evidence: TAS. Frequency: Frequent (HP:0040282). (ORPHA:314769)
- Kyphosis (HP:0002808): Exaggerated anterior convexity of the thoracic vertebral column. Evidence: TAS. Frequency: Frequent (HP:0040282). (ORPHA:314769)
- Pituitary adenoma (HP:0002893): A benign epithelial tumor derived from intrinsic cells of the adenohypophysis (anterior pituitary). Evidence: TAS. Frequency: Frequent (HP:0040282). (ORPHA:314769)
- Paresthesia (HP:0003401): Abnormal sensations such as tingling, pricking, or numbness of the skin with no apparent physical cause. Evidence: TAS. Frequency: Frequent (HP:0040282). (ORPHA:314769)
- Spinal canal stenosis (HP:0003416): An abnormal narrowing of the spinal canal. Evidence: TAS. Frequency: Frequent (HP:0040282). (ORPHA:314769)
- Pituitary prolactin cell adenoma (HP:0006767): A type of pituitary adenoma originating in prolactin secreting cells. This kind of adenoma is characterized by overproduction of prolactin, and may cause loss of menstrual periods and breast milk production in women. Evidence: TAS. Frequency: Frequent (HP:0040282). (ORPHA:314769)
- Abnormal toenail morphology (HP:0008388): An anomaly of the toenail. Evidence: TAS. Frequency: Frequent (HP:0040282). (ORPHA:314769)
- Sleep apnea (HP:0010535): An intermittent cessation of airflow at the mouth and nose during sleep is known as sleep apnea. Apneas that last at least 10 seconds are considered significant, but individuals with sleep apnea may experience apneas lasting from 20 seconds up to 2 or 3 minutes. Patients may have up to 15 events per hour of sleep. Evidence: TAS. Frequency: Frequent (HP:0040282). (ORPHA:314769)
- Pituitary growth hormone cell adenoma (HP:0011760): A type of pituitary adenoma that produces growth hormone. Evidence: TAS. Frequency: Frequent (HP:0040282). (ORPHA:314769)
- Broad jaw (HP:0012802): Bigonial distance (lower facial width) more than 2 SD above the mean (objective); or an apparently increased width of the lower jaw (mandible) when viewed from the front (subjective). Evidence: TAS. Frequency: Frequent (HP:0040282). (ORPHA:314769)
- Cerebral palsy (HP:0100021): Cerebral palsy describes a group of permanent disorders of the development of movement and posture, causing activity limitation, that are attributed to nonprogressive disturbances that occurred in the developing fetal or infant brain. The motor disorders of cerebral palsy are often accompanied by disturbances of sensation, perception, cognition, communication, and behavior, by epilepsy, and by secondary musculoskeletal problems. Evidence: TAS. Frequency: Frequent (HP:0040282). (ORPHA:314769)
- Palpebral edema (HP:0100540): Edema in the region of the eyelids. Evidence: TAS. Frequency: Frequent (HP:0040282). (ORPHA:314769)
- Dysmenorrhea (HP:0100607): Pain during menstruation that interferes with daily activities. Evidence: TAS. Frequency: Frequent (HP:0040282). (ORPHA:314769)
- Galactorrhea (HP:0100829): Spontaneous flow of milk from the breast, unassociated with childbirth or nursing. Evidence: TAS. Frequency: Frequent (HP:0040282). (ORPHA:314769)
- Impotence (HP:0000802): Inability to develop or maintain an erection of the penis. Evidence: TAS. Frequency: Occasional (HP:0040283). (ORPHA:314769)
- Acanthosis nigricans (HP:0000956): A dermatosis characterized by thickened, hyperpigmented plaques, typically on the intertriginous surfaces and neck. Evidence: TAS. Frequency: Occasional (HP:0040283). (ORPHA:314769)
- Hypertrophic cardiomyopathy (HP:0001639): Hypertrophic cardiomyopathy (HCM) is defined by the presence of increased ventricular wall thickness or mass in the absence of loading conditions (hypertension, valve disease) sufficient to cause the observed abnormality. Evidence: TAS. Frequency: Occasional (HP:0040283). (ORPHA:314769)
- Mitral regurgitation (HP:0001653): An abnormality of the mitral valve characterized by insufficiency or incompetence of the mitral valve resulting in retrograde leaking of blood through the mitral valve upon ventricular contraction. Evidence: TAS. Frequency: Occasional (HP:0040283). (ORPHA:314769)
- Generalized hyperpigmentation (HP:0007440). Evidence: TAS. Frequency: Occasional (HP:0040283). (ORPHA:314769)
- Dysuria (HP:0100518): Painful or difficult urination. Evidence: TAS. Frequency: Occasional (HP:0040283). (ORPHA:314769)
- Excessive daytime somnolence (HP:0001262): A state of abnormally strong desire for sleep during the daytime. Evidence: TAS. Frequency: Occasional (HP:0040283). (ORPHA:314769)
These phenotypes are associated with the disease Somatomammotropinoma (ORPHA:314769).